- Irregularly shaped sperm tail (HP:0033393): Irregular or changing caliber (diameter) along the tail of the sperm. Evidence: PCS. Frequency: 4/5. (PMID:37713809)
- Low semen volume (HP:6000135): Volume of semen in ejaculate below the lower limit of normal. This finding can be ascertained by semen analysis. Comment: Sperm are produced within the testis, in the process of spermatogenesis, then travel through the male reproductive tract (the seminiferous tubules, epididymis, vas deferens, prostate and urethra). As the sperm travel, seminal fluid is added from the seminal vesicles, prostate, testis and epididymis and periurethral glands. The function of the ejaculate is to transport sperm into the female genital tract and to provide a suitable environment for sperm survival during this transit. Evidence: PCS. Frequency: 0/5. (PMID:37713809)
- Reduced progressive sperm motility (HP:0034011): A reduced proportion of sperm that move in a straight line or large circles; alternatively, an increased proportion of sperm that move in tight circles or in some other non-linear fashion. Evidence: PCS. Frequency: 5/5. (PMID:37713809)
- Coiled sperm flagella (HP:0032560): Sperm cells whose flagella are twisted (coiled). Evidence: PCS. Frequency: 0/5. (PMID:37713809)
- Male infertility (HP:0003251). Evidence: PCS. Frequency: 5/5. (PMID:37713809)
- Young adult onset (HP:0011462): Onset of disease at the age of between 16 and 40 years. Evidence: PCS. Frequency: 5/5. (PMID:37713809)
- Reduced sperm motility (HP:0012207): An abnormal reduction in the mobility of ejaculated sperm. Evidence: PCS. Frequency: 5/5. (PMID:37713809)
- Autosomal recessive inheritance (HP:0000007): A mode of inheritance that is observed for traits related to a gene encoded on one of the autosomes (i.e., the human chromosomes 1-22) in which a trait manifests in individuals with two pathogenic alleles, either homozygotes (two copies of the same mutant allele) or compound heterozygotes (whereby each copy of a gene has a distinct mutant allele). Evidence: PCS. (PMID:37713809)
- Bent sperm flagella (HP:0034811): The proportion of sperm cells whose flagella is sharply curved or has a sharp angle is above normal limits. Evidence: PCS. Frequency: 1/5. (PMID:37713809)
- Absent sperm flagella (HP:0032558): Sperm cells lacking flagella. Evidence: PCS. Frequency: 1/5. (PMID:37713809)
- Oligozoospermia (HP:0000798): Reduced count of spermatozoa in the semen, defined as a sperm count below 20 million per milliliter semen. Evidence: PCS. Frequency: 0/5. (PMID:37713809)
- Short sperm flagella (HP:0032559): Sperm cells with abnormally short flagella. Evidence: PCS. Frequency: 5/5. (PMID:37713809)
These phenotypes are associated with the disease spermatogenic failure 89 (OMIM:620705).